- Rigidity (HP:0002063): Continuous involuntary sustained muscle contraction. When an affected muscle is passively stretched, the degree of resistance remains constant regardless of the rate at which the muscle is stretched. This feature helps to distinguish rigidity from muscle spasticity. Evidence: TAS. Frequency: Very frequent (HP:0040281). (ORPHA:401849)
- Spastic gait (HP:0002064): Spasticity is manifested by increased stretch reflex which is intensified with movement velocity. This results in excessive and inappropriate muscle activation which can contribute to muscle hypertonia. Spastic gait is characterized by manifestations such as muscle hypertonia, stiff knee, and circumduction of the leg. Evidence: TAS. Frequency: Very frequent (HP:0040281). (ORPHA:401849)
- Pes cavus (HP:0001761): An increase in height of the medial longitudinal arch of the foot that does not flatten on weight bearing (i.e., a distinctly hollow form of the sole of the foot when it is bearing weight). Evidence: TAS. Frequency: Frequent (HP:0040282). (ORPHA:401849)
- Urinary bladder sphincter dysfunction (HP:0002839): Abnormal function of a sphincter of the urinary bladder. Evidence: TAS. Frequency: Frequent (HP:0040282). (ORPHA:401849)
- Postural tremor (HP:0002174): A type of tremors that is triggered by holding a limb in a fixed position. Evidence: TAS. Frequency: Occasional (HP:0040283). (ORPHA:401849)
- Memory impairment (HP:0002354): An impairment of memory as manifested by a reduced ability to remember things such as dates and names, and increased forgetfulness. Evidence: TAS. Frequency: Occasional (HP:0040283). (ORPHA:401849)
- Impaired vibration sensation at ankles (HP:0006938): A decrease in the ability to perceive vibration at the ankles. Clinically, this is usually tested with a tuning fork which vibrates at 128 Hz and is applied to the malleoli of the ankles. Evidence: TAS. Frequency: Occasional (HP:0040283). (ORPHA:401849)
- Abnormality of mental function (HP:0011446): Cognitive, psychiatric, or memory anomaly. Evidence: TAS. Frequency: Occasional (HP:0040283). (ORPHA:401849)
- Pain (HP:0012531): An unpleasant sensory and emotional experience associated with actual or potential tissue damage, or described in terms of such damage. Evidence: TAS. Frequency: Occasional (HP:0040283). (ORPHA:401849)
These phenotypes are associated with the disease Autosomal spastic paraplegia type 72 (ORPHA:401849).